- Absent tibia (HP:0009556): Absence of the tibia. Evidence: TAS. Frequency: Very frequent (HP:0040281). (ORPHA:1757)
- Abnormality of the face (HP:0000271): An abnormality of the face. Evidence: TAS. Frequency: Frequent (HP:0040282). (ORPHA:1757)
- Sacrococcygeal teratoma (HP:0030736): A teratoma arising in the sacro-coccygeal region. Evidence: TAS. Frequency: Frequent (HP:0040282). (ORPHA:1757)
These phenotypes are associated with the disease Fibular dimelia-diplopodia syndrome (ORPHA:1757).